- Increased total eosinophil count (HP:0001880): Increased count of eosinophils in the blood. Evidence: PCS. Frequency: 1/1. (PMID:33296702)
- Asthma (HP:0002099): Asthma is characterized by increased responsiveness of the tracheobronchial tree to multiple stimuli, leading to narrowing of the air passages with resultant dyspnea, cough, and wheezing. Evidence: PCS. Frequency: 1/1. (PMID:33296702)
- BCGosis (HP:0020087): Distant, or disseminated infection with Bacillus Calmette-Guerin (BCG) following vaccination associated with failure to contain thebacillus Calmette-Guerin (BCG) following vaccination leading to spread of BCG to many sites in the body. The tuberculosis vaccine BCG contains live attenuated Mycobacterium bovis. Evidence: PCS. Frequency: 1/1. Onset: Infantile onset (HP:0003593). (PMID:33296702)
- Infantile onset (HP:0003593): Onset of signs or symptoms of disease between 28 days to one year of life. Evidence: PCS. Frequency: 1/1. (PMID:33296702)
- Autosomal recessive inheritance (HP:0000007): A mode of inheritance that is observed for traits related to a gene encoded on one of the autosomes (i.e., the human chromosomes 1-22) in which a trait manifests in individuals with two pathogenic alleles, either homozygotes (two copies of the same mutant allele) or compound heterozygotes (whereby each copy of a gene has a distinct mutant allele). Evidence: PCS. (PMID:33296702)
These phenotypes are associated with the disease immunodeficiency 88 (OMIM:619630).